- Preauricular skin tag (HP:0000384): A rudimentary tag of skin often containing ear tissue including a core of cartilage and located just anterior to the auricle (outer part of the ear). Evidence: IEA. (OMIM:244300)
- Seizure (HP:0001250): A seizure is an intermittent abnormality of nervous system physiology characterized by a transient occurrence of signs and/or symptoms due to abnormal excessive or synchronous neuronal activity in the brain. Evidence: IEA. (OMIM:244300)
- Retinal coloboma (HP:0000480): A notch or cleft of the retina or choroid, located vertically below the optic disc. Evidence: PCS. (PMID:20358618)
- Camptodactyly of finger (HP:0100490): The distal interphalangeal joint and/or the proximal interphalangeal joint of the fingers cannot be extended to 180 degrees by either active or passive extension. Evidence: TAS. (OMIM:244300)
- Low posterior hairline (HP:0002162): Hair on the neck extends more inferiorly than usual. Evidence: IEA. (OMIM:244300)
- Severe intellectual disability (HP:0010864): Severe intellectual disability (ID) is defined as a type of ID characterized by severely sub-average adaptive functioning and intellectual functioning, with an intelligence quotient (IQ) the range of 20-34. Evidence: TAS. (OMIM:244300)
- Cataract (HP:0000518): A cataract is an opacity or clouding that develops in the crystalline lens of the eye or in its capsule. Evidence: IEA. (OMIM:244300)
- Ventricular septal defect (HP:0001629): A hole between the two bottom chambers (ventricles) of the heart. The defect is centered around the most superior aspect of the ventricular septum. Evidence: IEA. (OMIM:244300)
- Single transverse palmar crease (HP:0000954): The distal and proximal transverse palmar creases are merged into a single transverse palmar crease. Evidence: IEA. (OMIM:244300)
- Bulbous nose (HP:0000414): Increased volume and globular shape of the anteroinferior aspect of the nose. Evidence: IEA. (OMIM:244300)
- Iris coloboma (HP:0000612): A coloboma of the iris. Evidence: PCS. (PMID:1776630)
- Low hanging columella (HP:0009765): Columella extending inferior to the level of the nasal base, when viewed from the side. Evidence: IEA. (OMIM:244300)
- Hypoplastic labia majora (HP:0000059): Undergrowth of the outer labia. Evidence: IEA. (OMIM:244300)
- Pachygyria (HP:0001302): Pachygyria is a malformation of cortical development with abnormally wide gyri with sulci 1,5-3 cm apart and abnormally thick cortex measuring more than 5 mm (radiological definition). See also neuropathological definitions for 2-, 3-, and 4-layered lissencephaly. Evidence: IEA. (OMIM:244300)
- Patent ductus arteriosus (HP:0001643): In utero, the ductus arteriosus (DA) serves to divert ventricular output away from the lungs and toward the placenta by connecting the main pulmonary artery to the descending aorta. A patent ductus arteriosus (PDA) in the first 3 days of life is a physiologic shunt in healthy term and preterm newborn infants, and normally is substantially closed within about 24 hours after bith and completely closed after about three weeks. Failure of physiologcal closure is referred to a persistent or patent ductus arteriosus (PDA). Depending on the degree of left-to-right shunting, PDA can have clinical consequences. Evidence: IEA. (OMIM:244300)
- Constipation (HP:0002019): Infrequent or difficult evacuation of feces. Evidence: IEA. (OMIM:244300)
- Intellectual disability (HP:0001249): The term intellectual disability or intellectual developmental disorder is used to describe significantly sub-average intellectual and adaptive functioning based on clinical assessment and as measured by individually administered, appropriately normed, standardized and validated tests of intellectual functioning and adaptive behavior, with onset during the developmental period from infancy through adolescence. Evidence: IEA. (OMIM:244300)
- Clinodactyly of the 5th toe (HP:0001864): Bending or curvature of a fifth toe in the tibial direction (i.e., towards the big toe). Evidence: IEA. (OMIM:244300)
- Cleft palate (HP:0000175): Cleft palate is a developmental defect of the palate resulting from a failure of fusion of the palatine processes and manifesting as a separation of the roof of the mouth (soft and hard palate). Evidence: IEA. (OMIM:244300)
- Micropenis (HP:0000054): Abnormally small penis. At birth, the normal penis is about 3 cm (stretched length from pubic tubercle to tip of penis) with micropenis less than 2.0-2.5 cm. Evidence: IEA. (OMIM:244300)
- Abnormality of the urinary system (HP:0000079): An abnormality of the urinary system. Evidence: IEA. (OMIM:244300)
- Scoliosis (HP:0002650): The presence of an abnormal lateral curvature of the spine. Evidence: IEA. (OMIM:244300)
- Short neck (HP:0000470): Diminished length of the neck. Evidence: IEA. (OMIM:244300)
- Overlapping fingers (HP:0010557): A finger resting on the dorsal surface of an adjacent digit when the hand is at rest. Evidence: IEA. (OMIM:244300)
- Joint contracture of the hand (HP:0009473): Contractures of one ore more joints of the hands meaning chronic loss of joint motion due to structural changes in non-bony tissue. Evidence: IEA. (OMIM:244300)
- Autosomal recessive inheritance (HP:0000007): A mode of inheritance that is observed for traits related to a gene encoded on one of the autosomes (i.e., the human chromosomes 1-22) in which a trait manifests in individuals with two pathogenic alleles, either homozygotes (two copies of the same mutant allele) or compound heterozygotes (whereby each copy of a gene has a distinct mutant allele). Evidence: IEA. (OMIM:244300)
- Microphthalmia (HP:0000568): A developmental anomaly characterized by abnormal smallness of one or both eyes. Evidence: IEA. (OMIM:244300)
- Bilateral single transverse palmar creases (HP:0007598): The distal and proximal transverse palmar creases are merged into a single transverse palmar crease on both hands. Evidence: TAS. (OMIM:244300)
- Conductive hearing impairment (HP:0000405): An abnormality of vibrational conductance of sound to the inner ear leading to impairment of sensory perception of sound. Evidence: IEA. (OMIM:244300)
- Intrauterine growth retardation (HP:0001511): An abnormal restriction of fetal growth with fetal weight below the tenth percentile for gestational age. Evidence: IEA. (OMIM:244300)
- Atrial septal defect (HP:0001631): Atrial septal defect (ASD) is a congenital abnormality of the interatrial septum that enables blood flow between the left and right atria via the interatrial septum. Evidence: IEA. (OMIM:244300)
- Short thumb (HP:0009778): Hypoplasia (congenital reduction in size) of the thumb. Evidence: IEA. (OMIM:244300)
- Cleft upper lip (HP:0000204): A gap or groove in the upper lip. This is a congenital defect resulting from nonfusion of tissues of the lip during embryonal development. Evidence: IEA. (OMIM:244300)
- Cryptorchidism (HP:0000028): Testis in inguinal canal. That is, absence of one or both testes from the scrotum owing to failure of the testis or testes to descend through the inguinal canal to the scrotum. Evidence: IEA. (OMIM:244300)
- Intestinal malrotation (HP:0002566): An abnormality of the intestinal rotation and fixation that normally occurs during the development of the gut. This can lead to volvulus, or twisting of the intestine that causes obstruction and necrosis. Evidence: IEA. (OMIM:244300)
- Low-set ears (HP:0000369): Upper insertion of the ear to the scalp below an imaginary horizontal line drawn between the inner canthi of the eye and extending posteriorly to the ear. Evidence: IEA. (OMIM:244300)
- Polymicrogyria (HP:0002126): Polymicrogyria is a congenital malformation of the cerebral cortex characterized by abnormal cortical layering (lamination) and an excessive number of small gyri (folds). Evidence: IEA. (OMIM:244300)
These phenotypes are associated with the disease Kapur-Toriello syndrome (OMIM:244300).